Phenotypes associated with the disease Neurodegeneration due to 3-hydroxyisobutyryl-CoA hydrolase deficiency (ORPHA:88639):
- Hypotonia (HP:0001252): Hypotonia is an abnormally low muscle tone (the amount of tension or resistance to movement in a muscle). Even when relaxed, muscles have a continuous and passive partial contraction which provides some resistance to passive stretching. Hypotonia thus manifests as diminished resistance to passive stretching. Hypotonia is not the same as muscle weakness, although the two conditions can co-exist. Evidence: TAS. Frequency: Very frequent (HP:0040281). (ORPHA:88639)
- Motor delay (HP:0001270): A type of Developmental delay characterized by a delay in acquiring motor skills. Evidence: TAS. Frequency: Very frequent (HP:0040281). (ORPHA:88639)
- Dystonia (HP:0001332): An abnormally increased muscular tone that causes fixed abnormal postures. There is a slow, intermittent twisting motion that leads to exaggerated turning and posture of the extremities and trunk. Evidence: TAS. Frequency: Very frequent (HP:0040281). (ORPHA:88639)
- Vomiting (HP:0002013): Forceful ejection of the contents of the stomach through the mouth by means of a series of involuntary spasmic contractions. Evidence: TAS. Frequency: Very frequent (HP:0040281). (ORPHA:88639)
- Progressive neurologic deterioration (HP:0002344). Evidence: TAS. Frequency: Very frequent (HP:0040281). (ORPHA:88639)
- Epicanthus (HP:0000286): A fold of skin starting above the medial aspect of the upper eyelid and arching downward to cover, pass in front of and lateral to the medial canthus. Evidence: TAS. Frequency: Frequent (HP:0040282). (ORPHA:88639)
- Strabismus (HP:0000486): A misalignment of the eyes so that the visual axes deviate from bifoveal fixation. The classification of strabismus may be based on a number of features including the relative position of the eyes, whether the deviation is latent or manifest, intermittent or constant, concomitant or otherwise and according to the age of onset and the relevance of any associated refractive error. Evidence: TAS. Frequency: Frequent (HP:0040282). (ORPHA:88639)
- Nystagmus (HP:0000639): Rhythmic, involuntary oscillations of one or both eyes related to abnormality in fixation, conjugate gaze, or vestibular mechanisms. Evidence: TAS. Frequency: Frequent (HP:0040282). (ORPHA:88639)
- Seizure (HP:0001250): A seizure is an intermittent abnormality of nervous system physiology characterized by a transient occurrence of signs and/or symptoms due to abnormal excessive or synchronous neuronal activity in the brain. Evidence: TAS. Frequency: Frequent (HP:0040282). (ORPHA:88639)
- Hyperreflexia (HP:0001347): Hyperreflexia is the presence of hyperactive stretch reflexes of the muscles. Evidence: TAS. Frequency: Frequent (HP:0040282). (ORPHA:88639)
- Failure to thrive (HP:0001508): Failure to thrive (FTT) refers to a child whose physical growth is substantially below the norm. Evidence: TAS. Frequency: Frequent (HP:0040282). (ORPHA:88639)
- Metabolic acidosis (HP:0001942): Metabolic acidosis (MA) is characterized by a fall in blood pH due to a reduction of serum bicarbonate concentration. This can occur as a result of either the accumulation of acids (high anion gap MA) or the loss of bicarbonate from the gastrointestinal tract or the kidney (hyperchloremic MA). By definition, MA is not due to a respirary cause. Evidence: TAS. Frequency: Frequent (HP:0040282). (ORPHA:88639)
- Truncal ataxia (HP:0002078): Truncal ataxia is a sign of ataxia characterized by instability of the trunk. It usually occurs during sitting. Evidence: TAS. Frequency: Frequent (HP:0040282). (ORPHA:88639)
- Ventriculomegaly (HP:0002119): An increase in size of the ventricular system of the brain. Evidence: TAS. Frequency: Frequent (HP:0040282). (ORPHA:88639)
- Increased circulating lactate concentration (HP:0002151): Abnormally increased level of blood lactate (2-hydroxypropanoic acid). Lactate is produced from pyruvate by lactate dehydrogenase during normal metabolism. The terms lactate and lactic acid are often used interchangeably but lactate (the component measured in blood) is strictly a weak base whereas lactic acid is the corresponding acid. Lactic acidosis is often used clinically to describe elevated lactate but should be reserved for cases where there is a corresponding acidosis (pH below 7.35). Evidence: TAS. Frequency: Frequent (HP:0040282). (ORPHA:88639)
- Sleep disturbance (HP:0002360): An abnormal pattern in the quality, quantity, or characteristics of sleep. Evidence: TAS. Frequency: Frequent (HP:0040282). (ORPHA:88639)
- Hypsarrhythmia (HP:0002521): Hypsarrhythmia is abnormal interictal high amplitude waves and a background of irregular spikes. There is continuous (during wakefulness), high-amplitude (>200 Hz), generalized polymorphic slowing with no organized background and multifocal spikes demonstrated by electroencephalography (EEG). Evidence: TAS. Frequency: Frequent (HP:0040282). (ORPHA:88639)
- Abnormality of mitochondrial metabolism (HP:0003287): A functional anomaly of mitochondria. Evidence: TAS. Frequency: Frequent (HP:0040282). (ORPHA:88639)
- Abnormal vertebral morphology (HP:0003468): An abnormality of one or more of the vertebrae. Evidence: TAS. Frequency: Frequent (HP:0040282). (ORPHA:88639)
- Aplasia/Hypoplasia of the corpus callosum (HP:0007370): Absence or underdevelopment of the corpus callosum. Evidence: TAS. Frequency: Frequent (HP:0040282). (ORPHA:88639)
- Facial shape deformation (HP:0011334). Evidence: TAS. Frequency: Frequent (HP:0040282). (ORPHA:88639)
- Feeding difficulties (HP:0011968): Impaired ability to eat related to problems gathering food and getting ready to suck, chew, or swallow it. Evidence: TAS. Frequency: Frequent (HP:0040282). (ORPHA:88639)
- Infantile spasms (HP:0012469): Infantile spasms represent a subset of "epileptic spasms". Infantile Spasms are epileptic spasms starting in the first year of life (infancy). Evidence: TAS. Frequency: Frequent (HP:0040282). (ORPHA:88639)
- Cryptorchidism (HP:0000028): Testis in inguinal canal. That is, absence of one or both testes from the scrotum owing to failure of the testis or testes to descend through the inguinal canal to the scrotum. Evidence: TAS. Frequency: Occasional (HP:0040283). (ORPHA:88639)
- Irritability (HP:0000737): An emotional state characterized by negative feelings of heightened frustration, annoyance, or feeling upset, often triggered by internal factors (e.g., fatigue, hunger, unfulfilled desires) or external factors (e.g., social or environmental challenges). Irritability may be unpredictable, and is accompanied by a lowered threshold for emotional reactivity and observable features (speech, facial expressions, or psychomotor activity). Evidence: TAS. Frequency: Occasional (HP:0040283). (ORPHA:88639)
- Encephalopathy (HP:0001298): Encephalopathy is a term that means brain disease, damage, or malfunction. In general, encephalopathy is manifested by an altered mental state. Evidence: TAS. Frequency: Occasional (HP:0040283). (ORPHA:88639)
- Respiratory insufficiency (HP:0002093). Evidence: TAS. Frequency: Occasional (HP:0040283). (ORPHA:88639)
- Leukoencephalopathy (HP:0002352): This term describes abnormality of the white matter of the cerebrum resulting from damage to the myelin sheaths of nerve cells. Evidence: TAS. Frequency: Occasional (HP:0040283). (ORPHA:88639)
- Small basal ganglia (HP:0012697): Decreased size of the basal ganglia. Evidence: TAS. Frequency: Occasional (HP:0040283). (ORPHA:88639)
- Tetralogy of Fallot (HP:0001636): A congenital cardiac malformation comprising pulmonary stenosis, overriding aorta, ventricular septum defect, and right ventricular hypertrophy. The diagnosis of TOF is made if at least three of the four above mentioned features are present. Evidence: TAS. Frequency: Very rare (HP:0040284). (ORPHA:88639)
- Head titubation (HP:0002599): A head tremor of moderate speed (3 to 4 Hz) in the anterior-posterior direction. Evidence: TAS. Frequency: Very rare (HP:0040284). (ORPHA:88639)